Phenotypes associated with the disease syringomas, multiple (OMIM:186600):
- Autosomal dominant inheritance (HP:0000006): A mode of inheritance that is observed for traits related to a gene encoded on one of the autosomes (i.e., the human chromosomes 1-22) in which a trait manifests in heterozygotes. In the context of medical genetics, an autosomal dominant disorder is caused when a single copy of the mutant allele is present. Males and females are affected equally, and can both transmit the disorder with a risk of 50% for each child of inheriting the mutant allele. Evidence: IEA. (OMIM:186600)
- Abnormality of the skin (HP:0000951): An abnormality of the skin. Evidence: IEA. (OMIM:186600)